- Dry skin (HP:0000958): Skin characterized by the lack of natural or normal moisture. Evidence: TAS. Frequency: Very frequent (HP:0040281). (ORPHA:1954)
- Urticaria (HP:0001025): Raised, well-circumscribed areas of erythema and edema involving the dermis and epidermis. Urticaria is intensely pruritic, and blanches completely with pressure. Evidence: TAS. Frequency: Very frequent (HP:0040281). (ORPHA:1954)
- Failure to thrive (HP:0001508): Failure to thrive (FTT) refers to a child whose physical growth is substantially below the norm. Evidence: TAS. Frequency: Very frequent (HP:0040281). (ORPHA:1954)
- Death in infancy (HP:0001522): Death within the first 24 months of life. Evidence: TAS. Frequency: Very frequent (HP:0040281). (ORPHA:1954)
- Malabsorption (HP:0002024): Impaired ability to absorb one or more nutrients from the intestine. Evidence: TAS. Frequency: Very frequent (HP:0040281). (ORPHA:1954)
- Respiratory insufficiency (HP:0002093). Evidence: TAS. Frequency: Very frequent (HP:0040281). (ORPHA:1954)
- Hypoalbuminemia (HP:0003073): The concentration of albumin in the blood circulation is below the lower limit of normal. Evidence: TAS. Frequency: Very frequent (HP:0040281). (ORPHA:1954)
- Congenital exfoliative erythroderma (HP:0007381). Evidence: TAS. Frequency: Very frequent (HP:0040281). (ORPHA:1954)
- Ichthyosis (HP:0008064): An abnormality of the skin characterized the presence of excessive amounts of dry surface scales on the skin resulting from an abnormality of keratinization. Evidence: TAS. Frequency: Very frequent (HP:0040281). (ORPHA:1954)
These phenotypes are associated with the disease Congenital lethal erythroderma (ORPHA:1954).